- Intellectual disability (HP:0001249): The term intellectual disability or intellectual developmental disorder is used to describe significantly sub-average intellectual and adaptive functioning based on clinical assessment and as measured by individually administered, appropriately normed, standardized and validated tests of intellectual functioning and adaptive behavior, with onset during the developmental period from infancy through adolescence. Evidence: IEA. (OMIM:300709)
This phenotype is associated with the disease syndromic X-linked intellectual disability Shrimpton type (OMIM:300709).